Phenotypes associated with the disease atrioventricular septal defect, susceptibility to, 2 (OMIM:606217):
- Congenital onset (HP:0003577): A phenotypic abnormality that is present at birth. Evidence: PCS. Frequency: 3/3. (PMID:12632326)
- Dextrocardia (HP:0001651): The heart is located in the right hand sided hemithorax. That is, there is a left-right reversal (or "mirror reflection") of the anatomical location of the heart in which the heart is locate on the right side instead of the left. Evidence: PCS. Frequency: 1/3. (PMID:12632326)
- Typified by incomplete penetrance (HP:0003829): Description of conditions in which not all individuals with a given genotype exhibit the disease. Penetrance is the proportion that develop disease given a lifespan of 80 years. Evidence: PCS. (PMID:12632326)
- Right aortic arch with mirror image branching (HP:0002627): The aortic arch crosses the right mainstem bronchus and not the left mainstem bronchus, but does not result in the creation of a vascular ring. The first branch is the left brachiocephalic artery which divides into the left carotid artery and left subclavian artery, the second branch is the right carotid artery, the third branch is the right subclavian artery. Evidence: PCS. Frequency: 1/3. (PMID:12632326)
- Partial atrioventricular canal defect (HP:0011577): A specific combination of heart defects including a primum atrial septal defect and cleft anterior mitral valve leaflet. There is not an inlet ventricular septal defect present. There are two valve annuluses and two valve orifices. Evidence: PCS. Frequency: 3/3. (PMID:12632326)
- Pulmonary artery atresia (HP:0004935): A congenital anomaly with a narrowing or complete absence of the opening between the right ventricle and the pulmonary artery. Evidence: PCS. Frequency: 1/3. (PMID:12632326)
- Autosomal dominant inheritance (HP:0000006): A mode of inheritance that is observed for traits related to a gene encoded on one of the autosomes (i.e., the human chromosomes 1-22) in which a trait manifests in heterozygotes. In the context of medical genetics, an autosomal dominant disorder is caused when a single copy of the mutant allele is present. Males and females are affected equally, and can both transmit the disorder with a risk of 50% for each child of inheriting the mutant allele. Evidence: PCS. (PMID:12632326)